Phenotypes associated with the disease ALG1-CDG (ORPHA:79327):
- Intellectual disability (HP:0001249): The term intellectual disability or intellectual developmental disorder is used to describe significantly sub-average intellectual and adaptive functioning based on clinical assessment and as measured by individually administered, appropriately normed, standardized and validated tests of intellectual functioning and adaptive behavior, with onset during the developmental period from infancy through adolescence. Evidence: TAS. Frequency: Very frequent (HP:0040281). (ORPHA:79327)
- Seizure (HP:0001250): A seizure is an intermittent abnormality of nervous system physiology characterized by a transient occurrence of signs and/or symptoms due to abnormal excessive or synchronous neuronal activity in the brain. Evidence: TAS. Frequency: Very frequent (HP:0040281). (ORPHA:79327)
- Hypotonia (HP:0001252): Hypotonia is an abnormally low muscle tone (the amount of tension or resistance to movement in a muscle). Even when relaxed, muscles have a continuous and passive partial contraction which provides some resistance to passive stretching. Hypotonia thus manifests as diminished resistance to passive stretching. Hypotonia is not the same as muscle weakness, although the two conditions can co-exist. Evidence: TAS. Frequency: Very frequent (HP:0040281). (ORPHA:79327)
- Global developmental delay (HP:0001263): A delay in the achievement of motor or mental milestones in the domains of development of a child, including motor skills, speech and language, cognitive skills, and social and emotional skills. This term should only be used to describe children younger than five years of age. Evidence: TAS. Frequency: Very frequent (HP:0040281). (ORPHA:79327)
- Progressive microcephaly (HP:0000253): Progressive microcephaly is diagnosed when the head circumference falls progressively behind age- and gender-dependent norms. Evidence: TAS. Frequency: Frequent (HP:0040282). (ORPHA:79327)
- Abnormality of the eye (HP:0000478): Any abnormality of the eye, including location, spacing, and intraocular abnormalities. Evidence: TAS. Frequency: Frequent (HP:0040282). (ORPHA:79327)
- Strabismus (HP:0000486): A misalignment of the eyes so that the visual axes deviate from bifoveal fixation. The classification of strabismus may be based on a number of features including the relative position of the eyes, whether the deviation is latent or manifest, intermittent or constant, concomitant or otherwise and according to the age of onset and the relevance of any associated refractive error. Evidence: TAS. Frequency: Frequent (HP:0040282). (ORPHA:79327)
- Abnormality of the skeletal system (HP:0000924): An abnormality of the skeletal system. Evidence: TAS. Frequency: Frequent (HP:0040282). (ORPHA:79327)
- Mild intellectual disability (HP:0001256): Mild intellectual disability (ID) is defined as a type of ID characterized by mildly sub-average adaptive functioning and intellectual functioning, with an intelligence quotient (IQ) the range of 50-69. Evidence: TAS. Frequency: Frequent (HP:0040282). (ORPHA:79327)
- Abnormality of blood and blood-forming tissues (HP:0001871): An abnormality of the hematopoietic system. Evidence: TAS. Frequency: Frequent (HP:0040282). (ORPHA:79327)
- Abnormal facial shape (HP:0001999): An abnormal morphology (form) of the face or its components. Evidence: TAS. Frequency: Frequent (HP:0040282). (ORPHA:79327)
- Chronic diarrhea (HP:0002028): The presence of chronic diarrhea, which is usually taken to mean diarrhea that has persisted for over 4 weeks. Evidence: TAS. Frequency: Frequent (HP:0040282). (ORPHA:79327)
- Scoliosis (HP:0002650): The presence of an abnormal lateral curvature of the spine. Evidence: TAS. Frequency: Frequent (HP:0040282). (ORPHA:79327)
- Hypoalbuminemia (HP:0003073): The concentration of albumin in the blood circulation is below the lower limit of normal. Evidence: TAS. Frequency: Frequent (HP:0040282). (ORPHA:79327)
- Abnormality of the gastrointestinal tract (HP:0011024): An abnormality of the gastrointestinal tract. Evidence: TAS. Frequency: Frequent (HP:0040282). (ORPHA:79327)
- Severe global developmental delay (HP:0011344): A severe delay in the achievement of motor or mental milestones in the domains of development of a child. Evidence: TAS. Frequency: Frequent (HP:0040282). (ORPHA:79327)
- Brain imaging abnormality (HP:0410263): An anomaly of metabolism or structure of the brain identified by imaging. Evidence: TAS. Frequency: Frequent (HP:0040282). (ORPHA:79327)
- Abnormality of the kidney (HP:0000077): An abnormality of the kidney. Evidence: TAS. Frequency: Occasional (HP:0040283). (ORPHA:79327)
- Renal insufficiency (HP:0000083): A reduction in the level of performance of the kidneys in areas of function comprising the concentration of urine, removal of wastes, the maintenance of electrolyte balance, homeostasis of blood pressure, and calcium metabolism. Evidence: TAS. Frequency: Occasional (HP:0040283). (ORPHA:79327)
- Nephrotic syndrome (HP:0000100): Nephrotic syndrome is a collection of findings resulting from glomerular dysfunction with an increase in glomerular capillary wall permeability associated with pronounced proteinuria. Nephrotic syndrome refers to the constellation of clinical findings that result from severe renal loss of protein, with Proteinuria and hypoalbuminemia, edema, and hyperlipidemia. Evidence: TAS. Frequency: Occasional (HP:0040283). (ORPHA:79327)
- Nystagmus (HP:0000639): Rhythmic, involuntary oscillations of one or both eyes related to abnormality in fixation, conjugate gaze, or vestibular mechanisms. Evidence: TAS. Frequency: Occasional (HP:0040283). (ORPHA:79327)
- Cerebellar atrophy (HP:0001272): Cerebellar atrophy is defined as a cerebellum with initially normal structures, in a posterior fossa with normal size, which displays enlarged fissures (interfolial spaces) in comparison to the foliae secondary to loss of tissue. Cerebellar atrophy implies irreversible loss of tissue and result from an ongoing progressive disease until a final stage is reached or a single injury, e.g. an intoxication or infectious event. Evidence: TAS. Frequency: Occasional (HP:0040283). (ORPHA:79327)
- Limitation of joint mobility (HP:0001376): A reduction in the freedom of movement of one or more joints. Evidence: TAS. Frequency: Occasional (HP:0040283). (ORPHA:79327)
- Decreased liver function (HP:0001410): Reduced ability of the liver to perform its functions. Evidence: TAS. Frequency: Occasional (HP:0040283). (ORPHA:79327)
- Abnormal heart morphology (HP:0001627): Any structural anomaly of the heart. Evidence: TAS. Frequency: Occasional (HP:0040283). (ORPHA:79327)
- Cardiomyopathy (HP:0001638): A myocardial disorder in which the heart muscle is structurally and functionally abnormal, in the absence of coronary artery disease, hypertension, valvular disease and congenital heart disease sufficient to cause the observed myocardial abnormality. Evidence: TAS. Frequency: Occasional (HP:0040283). (ORPHA:79327)
- Cerebral atrophy (HP:0002059): Atrophy (wasting, decrease in size of cells or tissue) affecting the cerebrum. Evidence: TAS. Frequency: Occasional (HP:0040283). (ORPHA:79327)
- Protein-losing enteropathy (HP:0002243): Abnormal loss of protein from the digestive tract related to excessive leakage of plasma proteins into the lumen of the gastrointestinal tract. Evidence: TAS. Frequency: Occasional (HP:0040283). (ORPHA:79327)
- Recurrent infections (HP:0002719): Increased susceptibility to infections as manifested by repeated bouts of infection. Evidence: TAS. Frequency: Occasional (HP:0040283). (ORPHA:79327)
- Immunodeficiency (HP:0002721): Failure of the immune system to protect the body adequately from infection, due to the absence or insufficiency of some component process or substance. Evidence: TAS. Frequency: Occasional (HP:0040283). (ORPHA:79327)
- Kyphosis (HP:0002808): Exaggerated anterior convexity of the thoracic vertebral column. Evidence: TAS. Frequency: Occasional (HP:0040283). (ORPHA:79327)
- Respiratory failure (HP:0002878): A severe form of respiratory insufficiency characterized by inadequate gas exchange such that the levels of oxygen or carbon dioxide cannot be maintained within normal limits. Evidence: TAS. Frequency: Occasional (HP:0040283). (ORPHA:79327)
- Sepsis (HP:0100806): Sepsis is defined as life-threatening organ dysfunction caused by a dysregulated host response to infection. Evidence: TAS. Frequency: Occasional (HP:0040283). (ORPHA:79327)